- Posteriorly rotated ears (HP:0000358): A type of abnormal location of the ears in which the position of the ears is characterized by posterior rotation (the superior part of the ears is rotated towards the back of the head, and the inferior part of the ears towards the front). Evidence: TAS. Frequency: Occasional (HP:0040283). (ORPHA:79328)
- Intellectual disability (HP:0001249): The term intellectual disability or intellectual developmental disorder is used to describe significantly sub-average intellectual and adaptive functioning based on clinical assessment and as measured by individually administered, appropriately normed, standardized and validated tests of intellectual functioning and adaptive behavior, with onset during the developmental period from infancy through adolescence. Evidence: TAS. Frequency: Very frequent (HP:0040281). (ORPHA:79328)
- Seizure (HP:0001250): A seizure is an intermittent abnormality of nervous system physiology characterized by a transient occurrence of signs and/or symptoms due to abnormal excessive or synchronous neuronal activity in the brain. Evidence: TAS. Frequency: Very frequent (HP:0040281). (ORPHA:79328)
- Global developmental delay (HP:0001263): A delay in the achievement of motor or mental milestones in the domains of development of a child, including motor skills, speech and language, cognitive skills, and social and emotional skills. This term should only be used to describe children younger than five years of age. Evidence: TAS. Frequency: Very frequent (HP:0040281). (ORPHA:79328)
- Progressive microcephaly (HP:0000253): Progressive microcephaly is diagnosed when the head circumference falls progressively behind age- and gender-dependent norms. Evidence: TAS. Frequency: Frequent (HP:0040282). (ORPHA:79328)
- Hypotonia (HP:0001252): Hypotonia is an abnormally low muscle tone (the amount of tension or resistance to movement in a muscle). Even when relaxed, muscles have a continuous and passive partial contraction which provides some resistance to passive stretching. Hypotonia thus manifests as diminished resistance to passive stretching. Hypotonia is not the same as muscle weakness, although the two conditions can co-exist. Evidence: TAS. Frequency: Frequent (HP:0040282). (ORPHA:79328)
- Abnormal heart morphology (HP:0001627): Any structural anomaly of the heart. Evidence: TAS. Frequency: Frequent (HP:0040282). (ORPHA:79328)
- Pericardial effusion (HP:0001698): Accumulation of fluid within the pericardium. Evidence: TAS. Frequency: Frequent (HP:0040282). (ORPHA:79328)
- Hepatomegaly (HP:0002240): Abnormally increased size of the liver. Evidence: TAS. Frequency: Frequent (HP:0040282). (ORPHA:79328)
- Skeletal dysplasia (HP:0002652): A general term describing features characterized by abnormal development of bones and connective tissues. Evidence: TAS. Frequency: Frequent (HP:0040282). (ORPHA:79328)
- Inverted nipples (HP:0003186): The presence of nipples that instead of pointing outward are retracted inwards. Evidence: TAS. Frequency: Frequent (HP:0040282). (ORPHA:79328)
- Enlarged kidney (HP:0000105): An abnormal increase in the size of the kidney. Evidence: TAS. Frequency: Occasional (HP:0040283). (ORPHA:79328)
- Hydronephrosis (HP:0000126): Severe distention of the kidney with dilation of the renal pelvis and calices. Evidence: TAS. Frequency: Occasional (HP:0040283). (ORPHA:79328)
- Wide mouth (HP:0000154): Distance between the oral commissures more than 2 SD above the mean. Alternatively, an apparently increased width of the oral aperture (subjective). Evidence: TAS. Frequency: Occasional (HP:0040283). (ORPHA:79328)
- Bifid uvula (HP:0000193): Uvula separated into two parts most easily seen at the tip. Evidence: TAS. Frequency: Occasional (HP:0040283). (ORPHA:79328)
- Thin upper lip vermilion (HP:0000219): Height of the vermilion of the upper lip in the midline more than 2 SD below the mean. Alternatively, an apparently reduced height of the vermilion of the upper lip in the frontal view (subjective). Evidence: TAS. Frequency: Occasional (HP:0040283). (ORPHA:79328)
- Brachycephaly (HP:0000248): An abnormality of skull shape characterized by a decreased anterior-posterior diameter. That is, a cephalic index greater than 81%. Alternatively, an apparently shortened anteroposterior dimension (length) of the head compared to width. Evidence: TAS. Frequency: Occasional (HP:0040283). (ORPHA:79328)
- Wide anterior fontanel (HP:0000260): Enlargement of the anterior fontanelle with respect to age-dependent norms. Evidence: TAS. Frequency: Occasional (HP:0040283). (ORPHA:79328)
- Delayed cranial suture closure (HP:0000270): Infants normally have two fontanels at birth, the diamond-shaped anterior fontanelle at the junction of the coronal and sagittal sutures, and the posterior fontanelle at the intersection of the occipital and parietal bones. The posterior fontanelle usually closes by the 8th week of life, and the anterior fontanel closes by the 18th month of life on average. This term applies if there is delay of closure of the fontanelles beyond the normal age. Evidence: TAS. Frequency: Occasional (HP:0040283). (ORPHA:79328)
- Microretrognathia (HP:0000308): A form of developmental hypoplasia of the mandible in which the mandible is mislocalised posteriorly. Evidence: TAS. Frequency: Occasional (HP:0040283). (ORPHA:79328)
- Hypertelorism (HP:0000316): Interpupillary distance more than 2 SD above the mean (alternatively, the appearance of an increased interpupillary distance or widely spaced eyes). Evidence: TAS. Frequency: Occasional (HP:0040283). (ORPHA:79328)
- Smooth philtrum (HP:0000319): Flat skin surface, with no ridge formation in the central region of the upper lip between the nasal base and upper vermilion border. Evidence: TAS. Frequency: Occasional (HP:0040283). (ORPHA:79328)
- Long philtrum (HP:0000343): Distance between nasal base and midline upper lip vermilion border more than 2 SD above the mean. Alternatively, an apparently increased distance between nasal base and midline upper lip vermilion border. Evidence: TAS. Frequency: Occasional (HP:0040283). (ORPHA:79328)
- Micrognathia (HP:0000347): Developmental hypoplasia of the mandible. Evidence: TAS. Frequency: Occasional (HP:0040283). (ORPHA:79328)
- Low-set ears (HP:0000369): Upper insertion of the ear to the scalp below an imaginary horizontal line drawn between the inner canthi of the eye and extending posteriorly to the ear. Evidence: TAS. Frequency: Occasional (HP:0040283). (ORPHA:79328)
- Underdeveloped nasal alae (HP:0000430): Thinned, deficient, or excessively arched ala nasi. Evidence: TAS. Frequency: Occasional (HP:0040283). (ORPHA:79328)
- Convex nasal ridge (HP:0000444): Nasal ridge curving anteriorly to an imaginary line that connects the nasal root and tip. The nose appears often also prominent, and the columella low. Evidence: TAS. Frequency: Occasional (HP:0040283). (ORPHA:79328)
- Short neck (HP:0000470): Diminished length of the neck. Evidence: TAS. Frequency: Occasional (HP:0040283). (ORPHA:79328)
- Torticollis (HP:0000473): Involuntary contractions of the neck musculature resulting in an abnormal posture of or abnormal movements of the head. Evidence: TAS. Frequency: Occasional (HP:0040283). (ORPHA:79328)
- Thickened nuchal skin fold (HP:0000474): A thickening of the skin thickness in the posterior aspect of the fetal neck. A nuchal fold (NF) measurement is obtained in a transverse section of the fetal head at the level of the cavum septum pellucidum and thalami, angled posteriorly to include the cerebellum. The measurement is taken from the outer edge of the occiput bone to the outer skin limit directly in the midline. An NF measurement greater than 5 mm at 14 to 17+6 weeks of gestation, or 6 mm at 18 to 28 weeks has been associated with a markedly increased risk for Down syndrome. Evidence: TAS. Frequency: Occasional (HP:0040283). (ORPHA:79328)
- Telecanthus (HP:0000506): Distance between the inner canthi more than two standard deviations above the mean (objective); or, apparently increased distance between the inner canthi. Evidence: TAS. Frequency: Occasional (HP:0040283). (ORPHA:79328)
- Proptosis (HP:0000520): An eye that is protruding anterior to the plane of the face to a greater extent than is typical. Evidence: TAS. Frequency: Occasional (HP:0040283). (ORPHA:79328)
- Esotropia (HP:0000565): A form of strabismus with one or both eyes turned inward ('crossed') to a relatively severe degree, usually defined as 10 diopters or more. Evidence: TAS. Frequency: Occasional (HP:0040283). (ORPHA:79328)
- Shallow orbits (HP:0000586): Reduced depth of the orbits associated with prominent-appearing ocular globes. Evidence: TAS. Frequency: Occasional (HP:0040283). (ORPHA:79328)
- Irritability (HP:0000737): An emotional state characterized by negative feelings of heightened frustration, annoyance, or feeling upset, often triggered by internal factors (e.g., fatigue, hunger, unfulfilled desires) or external factors (e.g., social or environmental challenges). Irritability may be unpredictable, and is accompanied by a lowered threshold for emotional reactivity and observable features (speech, facial expressions, or psychomotor activity). Evidence: TAS. Frequency: Occasional (HP:0040283). (ORPHA:79328)
- Bicornuate uterus (HP:0000813): The presence of a bicornuate uterus. Evidence: TAS. Frequency: Occasional (HP:0040283). (ORPHA:79328)
- Hypertrichosis (HP:0000998): Hypertrichosis is increased hair growth that is abnormal in quantity or location. Evidence: TAS. Frequency: Occasional (HP:0040283). (ORPHA:79328)
- Hitchhiker thumb (HP:0001234): With the hand relaxed and the thumb in the plane of the palm, the axis of the thumb forms an angle of at least 90 degrees with the long axis of the hand. Evidence: TAS. Frequency: Occasional (HP:0040283). (ORPHA:79328)
- Cerebellar atrophy (HP:0001272): Cerebellar atrophy is defined as a cerebellum with initially normal structures, in a posterior fossa with normal size, which displays enlarged fissures (interfolial spaces) in comparison to the foliae secondary to loss of tissue. Cerebellar atrophy implies irreversible loss of tissue and result from an ongoing progressive disease until a final stage is reached or a single injury, e.g. an intoxication or infectious event. Evidence: TAS. Frequency: Occasional (HP:0040283). (ORPHA:79328)
- Hyperreflexia (HP:0001347): Hyperreflexia is the presence of hyperactive stretch reflexes of the muscles. Evidence: TAS. Frequency: Occasional (HP:0040283). (ORPHA:79328)
- Periportal fibrosis (HP:0001405): The presence of fibrosis affecting the interlobular stroma of liver. Evidence: TAS. Frequency: Occasional (HP:0040283). (ORPHA:79328)
- Hepatic cysts (HP:0001407). Evidence: TAS. Frequency: Occasional (HP:0040283). (ORPHA:79328)
- Omphalocele (HP:0001539): A midline anterior incomplete closure of the abdominal wall in which there is herniation of the abdominal viscera into the base of the abdominal cord. Evidence: TAS. Frequency: Occasional (HP:0040283). (ORPHA:79328)
- Decreased fetal movement (HP:0001558): An abnormal reduction in quantity or strength of fetal movements. Evidence: TAS. Frequency: Occasional (HP:0040283). (ORPHA:79328)
- Oligohydramnios (HP:0001562): Diminished amniotic fluid volume in pregnancy. Evidence: TAS. Frequency: Occasional (HP:0040283). (ORPHA:79328)
- Ventricular septal defect (HP:0001629): A hole between the two bottom chambers (ventricles) of the heart. The defect is centered around the most superior aspect of the ventricular septum. Evidence: TAS. Frequency: Occasional (HP:0040283). (ORPHA:79328)
- Atrial septal defect (HP:0001631): Atrial septal defect (ASD) is a congenital abnormality of the interatrial septum that enables blood flow between the left and right atria via the interatrial septum. Evidence: TAS. Frequency: Occasional (HP:0040283). (ORPHA:79328)
- Talipes equinovarus (HP:0001762): Talipes equinovarus (also called clubfoot) typically has four main components: inversion and adduction of the forefoot; inversion of the heel and hindfoot; equinus (limitation of extension) of the ankle and subtalar joint; and internal rotation of the leg. Evidence: TAS. Frequency: Occasional (HP:0040283). (ORPHA:79328)
- Hydrops fetalis (HP:0001789): The abnormal accumulation of fluid in two or more fetal compartments, including ascites, pleural effusion, pericardial effusion, and skin edema. Evidence: TAS. Frequency: Occasional (HP:0040283). (ORPHA:79328)
- Frontal bossing (HP:0002007): Bilateral bulging of the lateral frontal bone prominences with relative sparing of the midline. Evidence: TAS. Frequency: Occasional (HP:0040283). (ORPHA:79328)
- Vomiting (HP:0002013): Forceful ejection of the contents of the stomach through the mouth by means of a series of involuntary spasmic contractions. Evidence: TAS. Frequency: Occasional (HP:0040283). (ORPHA:79328)
- Diarrhea (HP:0002014): Abnormally increased frequency (usually defined as three or more) loose or watery bowel movements a day. Evidence: TAS. Frequency: Occasional (HP:0040283). (ORPHA:79328)
- Gastroesophageal reflux (HP:0002020): A condition in which the stomach contents leak backwards from the stomach into the esophagus through the lower esophageal sphincter. Evidence: TAS. Frequency: Occasional (HP:0040283). (ORPHA:79328)
- Cerebral atrophy (HP:0002059): Atrophy (wasting, decrease in size of cells or tissue) affecting the cerebrum. Evidence: TAS. Frequency: Occasional (HP:0040283). (ORPHA:79328)
- Lower limb spasticity (HP:0002061): Spasticity (velocity-dependent increase in tonic stretch reflexes with increased muscle tone and hyperexcitable tendon reflexes) in the muscles of the lower limbs, hips, and pelvis. Evidence: TAS. Frequency: Occasional (HP:0040283). (ORPHA:79328)
- Pulmonary hypoplasia (HP:0002089). Evidence: TAS. Frequency: Occasional (HP:0040283). (ORPHA:79328)
- Asthma (HP:0002099): Asthma is characterized by increased responsiveness of the tracheobronchial tree to multiple stimuli, leading to narrowing of the air passages with resultant dyspnea, cough, and wheezing. Evidence: TAS. Frequency: Occasional (HP:0040283). (ORPHA:79328)
- Abnormal lung lobation (HP:0002101): A developmental defect in the formation of pulmonary lobes. Evidence: TAS. Frequency: Occasional (HP:0040283). (ORPHA:79328)
- Low posterior hairline (HP:0002162): Hair on the neck extends more inferiorly than usual. Evidence: TAS. Frequency: Occasional (HP:0040283). (ORPHA:79328)
- Large fleshy ears (HP:0002265). Evidence: TAS. Frequency: Occasional (HP:0040283). (ORPHA:79328)
- Hypoplastic nipples (HP:0002557): Underdevelopment of the nipple. Evidence: TAS. Frequency: Occasional (HP:0040283). (ORPHA:79328)
- Flared metaphysis (HP:0003015): The presence of a splayed (i.e.,flared) metaphyseal segment of one or more long bones. Evidence: TAS. Frequency: Occasional (HP:0040283). (ORPHA:79328)
- Short long bone (HP:0003026): One or more abnormally short long bone. Evidence: TAS. Frequency: Occasional (HP:0040283). (ORPHA:79328)
- Short nose (HP:0003196): Distance from nasion to subnasale more than two standard deviations below the mean, or alternatively, an apparently decreased length from the nasal root to the nasal tip. Evidence: TAS. Frequency: Occasional (HP:0040283). (ORPHA:79328)
- Narrow greater sciatic notch (HP:0003375): A narrowing of the sacrosciatic notch, i.e., the deep indentation in the posterior border of the hip bone at the point of union of the ilium and ischium. Evidence: TAS. Frequency: Occasional (HP:0040283). (ORPHA:79328)
- Right ventricular dilatation (HP:0005133): Enlargement of the chamber of the right ventricle, which can be defined echocardiographically as a right ventricular to left ventricular ratio greater than 1:1. Evidence: TAS. Frequency: Occasional (HP:0040283). (ORPHA:79328)
- Tricuspid regurgitation (HP:0005180): Failure of the tricuspid valve to close sufficiently upon contraction of the right ventricle, causing blood to regurgitate (flow backward) into the right atrium. Evidence: TAS. Frequency: Occasional (HP:0040283). (ORPHA:79328)
- Depressed nasal bridge (HP:0005280): Posterior positioning of the nasal root in relation to the overall facial profile for age. Evidence: TAS. Frequency: Occasional (HP:0040283). (ORPHA:79328)
- Hypoplasia of the bladder (HP:0005343): Underdevelopment of the urinary bladder. Evidence: TAS. Frequency: Occasional (HP:0040283). (ORPHA:79328)
- Prominent metopic ridge (HP:0005487): Vertical bony ridge positioned in the midline of the forehead. Evidence: TAS. Frequency: Occasional (HP:0040283). (ORPHA:79328)
- Aplasia cutis congenita of scalp (HP:0007385): A developmental defect resulting in the congenital absence of skin on the scalp. Evidence: TAS. Frequency: Occasional (HP:0040283). (ORPHA:79328)
- Hypoplasia of the ovary (HP:0008724): Developmental hypoplasia of the ovary. Evidence: TAS. Frequency: Occasional (HP:0040283). (ORPHA:79328)
- Abnormal renal artery morphology (HP:0008776): Any structural abnormality of the renal artery. Evidence: TAS. Frequency: Occasional (HP:0040283). (ORPHA:79328)
- Rhizomelia (HP:0008905): Disproportionate shortening of the proximal segment of limbs (i.e. the femur and humerus). Evidence: TAS. Frequency: Occasional (HP:0040283). (ORPHA:79328)
- Hypoplasia of the musculature (HP:0009004): Underdevelopment of the musculature. Evidence: TAS. Frequency: Occasional (HP:0040283). (ORPHA:79328)
- Lipodystrophy (HP:0009125): Degenerative changes of the fat tissue. Evidence: TAS. Frequency: Occasional (HP:0040283). (ORPHA:79328)
- Ulnar deviation of the hand (HP:0009487): Divergence of the longitudinal axis of the hand at the wrist in a posterior (ulnar) direction (i.e., towards the little finger). Evidence: TAS. Frequency: Occasional (HP:0040283). (ORPHA:79328)
- Low insertion of columella (HP:0010763): Insertion of the posterior columella below the nasal base. Evidence: TAS. Frequency: Occasional (HP:0040283). (ORPHA:79328)
- Abnormal left ventricular outflow tract morphology (HP:0011103): An abnormality of the outflow tract of the left ventricle. Evidence: TAS. Frequency: Occasional (HP:0040283). (ORPHA:79328)
- Villous atrophy (HP:0011473): The enteric villi are atrophic or absent. Evidence: TAS. Frequency: Occasional (HP:0040283). (ORPHA:79328)
- Abnormal bone ossification (HP:0011849): Any anomaly in the formation of bone or of a bony substance, or the conversion of fibrous tissue or of cartilage into bone or a bony substance. Evidence: TAS. Frequency: Occasional (HP:0040283). (ORPHA:79328)
- Delayed myelination (HP:0012448): Delayed myelination. Evidence: TAS. Frequency: Occasional (HP:0040283). (ORPHA:79328)
- Widened subarachnoid space (HP:0012704): An increase in size of the anatomic space between the arachnoid membrane and pia mater. Evidence: TAS. Frequency: Occasional (HP:0040283). (ORPHA:79328)
- Inappropriate crying (HP:0030215): Uncontrolled episodes of crying occur without any apparent motivating stimuli. Evidence: TAS. Frequency: Occasional (HP:0040283). (ORPHA:79328)
- Ureteral hypoplasia (HP:0032464): Underdevelopment of the ureter. Evidence: TAS. Frequency: Occasional (HP:0040283). (ORPHA:79328)
- Broad ischia (HP:0100865): Increased width of the ischium, which forms the lower and back part of the hip bone. Evidence: TAS. Frequency: Occasional (HP:0040283). (ORPHA:79328)
These phenotypes are associated with the disease ALG9-CDG (ORPHA:79328).